Phenotypes associated with the disease Scapula, contour of vertebral border of (OMIM:181300):
- Abnormality of the skeletal system (HP:0000924): An abnormality of the skeletal system. Evidence: IEA. (OMIM:181300)
- Autosomal dominant inheritance (HP:0000006): A mode of inheritance that is observed for traits related to a gene encoded on one of the autosomes (i.e., the human chromosomes 1-22) in which a trait manifests in heterozygotes. In the context of medical genetics, an autosomal dominant disorder is caused when a single copy of the mutant allele is present. Males and females are affected equally, and can both transmit the disorder with a risk of 50% for each child of inheriting the mutant allele. Evidence: IEA. (OMIM:181300)